- Glomerulonephritis (HP:0000099): Inflammation of the renal glomeruli. Evidence: PCS. Frequency: 1/1. (PMID:12149238)
- Middle age onset (HP:0003596): A type of adult onset with onset of symptoms at the age of 40 to 60 years. Evidence: PCS. Frequency: 1/1. (PMID:12149238)
- Recurrent shingles (HP:0032275): Repeated episodes of a localized, painful cutaneous eruption related to reactivation of varicella zoster virus (VZV) and characterized by a characteristic rash in one or two adjacent dermatomes. Evidence: PCS. Frequency: 1/1. (PMID:12149238)
- Autosomal recessive inheritance (HP:0000007): A mode of inheritance that is observed for traits related to a gene encoded on one of the autosomes (i.e., the human chromosomes 1-22) in which a trait manifests in individuals with two pathogenic alleles, either homozygotes (two copies of the same mutant allele) or compound heterozygotes (whereby each copy of a gene has a distinct mutant allele). Evidence: PCS. (PMID:12149238)
- Recurrent respiratory infections (HP:0002205): An increased susceptibility to respiratory infections as manifested by a history of recurrent respiratory infections. Evidence: PCS. Frequency: 0/1. (PMID:12149238)
These phenotypes are associated with the disease MHC class I deficiency 3 (OMIM:620814).